- Hypospadias (HP:0000047): Abnormal position of urethral meatus on the ventral penile shaft (underside) characterized by displacement of the urethral meatus from the tip of the glans penis to the ventral surface of the penis, scrotum, or perineum. Evidence: IEA. (OMIM:146450)
- Autosomal dominant inheritance (HP:0000006): A mode of inheritance that is observed for traits related to a gene encoded on one of the autosomes (i.e., the human chromosomes 1-22) in which a trait manifests in heterozygotes. In the context of medical genetics, an autosomal dominant disorder is caused when a single copy of the mutant allele is present. Males and females are affected equally, and can both transmit the disorder with a risk of 50% for each child of inheriting the mutant allele. Evidence: TAS. (OMIM:146450)
These phenotypes are associated with the disease hypospadias 3, autosomal (OMIM:146450).